- Abnormal cornea morphology (HP:0000481): Any abnormality of the cornea, which is the transparent tissue at the front of the eye that covers the iris, pupil, and anterior chamber. Evidence: TAS. Frequency: Very frequent (HP:0040281). (ORPHA:70476)
- Abnormal conjunctiva morphology (HP:0000502): An abnormality of the conjunctiva. Evidence: TAS. Frequency: Very frequent (HP:0040281). (ORPHA:70476)
- Abnormal sclera morphology (HP:0000591): An abnormality of the sclera. Evidence: TAS. Frequency: Very frequent (HP:0040281). (ORPHA:70476)
- Photophobia (HP:0000613): Excessive sensitivity to light with the sensation of discomfort or pain in the eyes due to exposure to bright light. Evidence: TAS. Frequency: Very frequent (HP:0040281). (ORPHA:70476)
- Keratoconjunctivitis (HP:0001096): Inflammation of the cornea and conjunctiva. Evidence: TAS. Frequency: Very frequent (HP:0040281). (ORPHA:70476)
- Allergic conjunctivitis (HP:0007879): Allergic Conjunctivitis is an allergic inflammation of the conjunctiva. Evidence: TAS. Frequency: Very frequent (HP:0040281). (ORPHA:70476)
- Epiphora (HP:0009926): Abnormally increased lacrimation, that is, excessive tearing (watering eye). Evidence: TAS. Frequency: Very frequent (HP:0040281). (ORPHA:70476)
- Corneal neovascularization (HP:0011496): Ingrowth of new blood vessels into the cornea. Evidence: TAS. Frequency: Very frequent (HP:0040281). (ORPHA:70476)
- Punctate keratitis (HP:0011859): A type of keratitis characterized by inflammation in pinpoint areas of the corneal epithelium. Evidence: TAS. Frequency: Very frequent (HP:0040281). (ORPHA:70476)
- Allergy (HP:0012393): An allergy is an immune response or reaction to substances that are usually not harmful. Evidence: TAS. Frequency: Very frequent (HP:0040281). (ORPHA:70476)
- Red eye (HP:0025337): A reddish appearance over the white part (sclera) of the eye ranging from a few enlarged blood vessels appearing as wiggly lines over the sclera to a bright red color completely covering to sclera. Evidence: TAS. Frequency: Very frequent (HP:0040281). (ORPHA:70476)
- Conjunctival hyperemia (HP:0030953): Dilatation of the blood vessels of the conjunctiva leading to a red appearance of the sclera. Evidence: TAS. Frequency: Very frequent (HP:0040281). (ORPHA:70476)
- Blurred vision (HP:0000622): Lack of sharpness of vision resulting in the inability to see fine detail. Evidence: TAS. Frequency: Frequent (HP:0040282). (ORPHA:70476)
- Blepharospasm (HP:0000643): A focal dystonia that affects the muscles of the eyelids and brow, associated with involuntary recurrent spasm of both eyelids. Evidence: TAS. Frequency: Frequent (HP:0040282). (ORPHA:70476)
- Giant conjunctival papillae (HP:0025350): Conjunctival papillae with a diameter greater than 1 millimeter. They characteristically have flattened tops which sometimes demonstrate staining with fluorescein. Evidence: TAS. Frequency: Frequent (HP:0040282). (ORPHA:70476)
- Ocular pruritus (HP:0033841): Pruritus is an itch or a sensation that makes a person want to scratch. This term refers to an abnormally increased sensation of itching in the region of the eye. Evidence: TAS. Frequency: Frequent (HP:0040282). (ORPHA:70476)
- Corneal foreign body sensation (HP:0034804): A perception that an object is in contact with the eye. Evidence: TAS. Frequency: Frequent (HP:0040282). (ORPHA:70476)
- Scarring (HP:0100699): A scar refers to a lesion in which wound, burn, or sore has not healed completely and fibrous connective tissue has developed. Evidence: TAS. Frequency: Frequent (HP:0040282). (ORPHA:70476)
- Blepharitis (HP:0000498): Inflammation of the eyelids. Evidence: TAS. Frequency: Occasional (HP:0040283). (ORPHA:70476)
- Keratoconus (HP:0000563): A cone-shaped deformity of the cornea characterized by the presence of corneal distortion secondary to thinning of the apex. Evidence: TAS. Frequency: Occasional (HP:0040283). (ORPHA:70476)
- Reduced visual acuity (HP:0007663). Evidence: TAS. Frequency: Occasional (HP:0040283). (ORPHA:70476)
- Corneal ulceration (HP:0012804): Disruption of the epithelial layer of the cornea with involvement of the underlying stroma. Evidence: TAS. Frequency: Occasional (HP:0040283). (ORPHA:70476)
- Limbal stem cell deficiency (HP:0032107): A condition characterized by a loss or deficiency of the stem cells in the limbus that are vital for re-population of the corneal epithelium and to the barrier function of the limbus. Evidence: TAS. Frequency: Very rare (HP:0040284). (ORPHA:70476)
These phenotypes are associated with the disease Vernal keratoconjunctivitis (ORPHA:70476).